- Motor deterioration (HP:0002333): Loss of previously present motor (i.e., movement) abilities. Evidence: IEA. (OMIM:601780)
- Abnormal nervous system electrophysiology (HP:0001311): An abnormality of the function of the electrical signals with which nerve cells communicate with each other or with muscles as measured by electrophysiological investigations. Evidence: IEA. (OMIM:601780)
- Progressive visual loss (HP:0000529): A reduction of previously attained ability to see. Evidence: IEA. (OMIM:601780)
- Seizure (HP:0001250): A seizure is an intermittent abnormality of nervous system physiology characterized by a transient occurrence of signs and/or symptoms due to abnormal excessive or synchronous neuronal activity in the brain. Evidence: IEA. (OMIM:601780)
- Increased neuronal autofluorescent lipopigment (HP:0002074): Lipofuscin, a generic term applied to autofluorescent lipopigment, is a mixture of protein and lipid that accumulates in most aging cells, particularly those involved in high lipid turnover (e.g., the adrenal medulla) or phagocytosis of other cell types (e g., the retinal pigment epithelium or RPE; macrophage). This term pertains if there is an increase in the neuronal accumulation of lipofuscin (also known as autofluorescent lipoprotein) more than expected for the age of the patient. Evidence: IEA. (OMIM:601780)
- Autosomal recessive inheritance (HP:0000007): A mode of inheritance that is observed for traits related to a gene encoded on one of the autosomes (i.e., the human chromosomes 1-22) in which a trait manifests in individuals with two pathogenic alleles, either homozygotes (two copies of the same mutant allele) or compound heterozygotes (whereby each copy of a gene has a distinct mutant allele). Evidence: IEA. (OMIM:601780)
- Retinal degeneration (HP:0000546): A nonspecific term denoting progressive loss of the retinal pigment epithelium (RPE) and/or neurosensory retinal cells. Evidence: IEA. (OMIM:601780)
- Fingerprint intracellular accumulation of autofluorescent lipopigment storage material (HP:0003208): An intracellular accumulation of autofluorescent lipopigment storage material in a trabecular or fingerprint-like pattern. Evidence: IEA. (OMIM:601780)
- Curvilinear intracellular accumulation of autofluorescent lipopigment storage material (HP:0003205): An intracellular accumulation of autofluorescent lipopigment storage material in a curved pattern. Evidence: IEA. (OMIM:601780)
These phenotypes are associated with the disease ceroid lipofuscinosis, neuronal, 6A (OMIM:601780).